Phenotypes associated with the disease Mesomelic dysplasia, Nievergelt type (ORPHA:2633):
- Limitation of joint mobility (HP:0001376): A reduction in the freedom of movement of one or more joints. Evidence: TAS. Frequency: Very frequent (HP:0040281). (ORPHA:2633)
- Genu valgum (HP:0002857): The legs angle inward, such that the knees are close together and the ankles far apart. Evidence: TAS. Frequency: Very frequent (HP:0040281). (ORPHA:2633)
- Radioulnar synostosis (HP:0002974): An abnormal osseous union (fusion) between the radius and the ulna. Evidence: TAS. Frequency: Very frequent (HP:0040281). (ORPHA:2633)
- Micromelia (HP:0002983): The presence of abnormally small extremities. Evidence: TAS. Frequency: Very frequent (HP:0040281). (ORPHA:2633)
- Abnormal fibula morphology (HP:0002991): An anomaly of the calf bone (fibula), one of the two bones of the calf. Evidence: TAS. Frequency: Very frequent (HP:0040281). (ORPHA:2633)
- Abnormal tibia morphology (HP:0002992): Abnormality of the tibia (shinbone). Evidence: TAS. Frequency: Very frequent (HP:0040281). (ORPHA:2633)
- Mesomelia (HP:0003027): Shortening of the middle parts of the limbs (forearm and lower leg) in relation to the upper and terminal segments. Evidence: TAS. Frequency: Very frequent (HP:0040281). (ORPHA:2633)
- Elbow dislocation (HP:0003042): Dislocation of the distal humerus out of the elbow joint, where the radius, ulna, and humerus meet. Evidence: TAS. Frequency: Very frequent (HP:0040281). (ORPHA:2633)
- Aplasia/Hypoplasia of the radius (HP:0006501): A small/hypoplastic or absent/aplastic radius. Evidence: TAS. Frequency: Very frequent (HP:0040281). (ORPHA:2633)
- Tarsal synostosis (HP:0008368): Synostosis (bony fusion) involving one or more bones of the tarsus (calcaneus, talus, cuboid, navicular, cuneiiform bones). Evidence: TAS. Frequency: Very frequent (HP:0040281). (ORPHA:2633)
- Mesomelic short stature (HP:0008845): A type of disproportionate short stature characterized by disproportionate shortening of the medial parts of the extremities (forearm or lower leg). Evidence: TAS. Frequency: Very frequent (HP:0040281). (ORPHA:2633)
- Skin dimple (HP:0010781): Skin dimples are cutaneous indentations that are the result of tethering of the skin to underlying structures (bone) causing an indentation. Evidence: TAS. Frequency: Very frequent (HP:0040281). (ORPHA:2633)
- Abnormal morphology of ulna (HP:0040071): Any structural anomaly of the ulna, a bone of the forearm the extends from the elbow to the little finger. Evidence: TAS. Frequency: Very frequent (HP:0040281). (ORPHA:2633)
- Camptodactyly of finger (HP:0100490): The distal interphalangeal joint and/or the proximal interphalangeal joint of the fingers cannot be extended to 180 degrees by either active or passive extension. Evidence: TAS. Frequency: Very frequent (HP:0040281). (ORPHA:2633)
- Brachycephaly (HP:0000248): An abnormality of skull shape characterized by a decreased anterior-posterior diameter. That is, a cephalic index greater than 81%. Alternatively, an apparently shortened anteroposterior dimension (length) of the head compared to width. Evidence: TAS. Frequency: Occasional (HP:0040283). (ORPHA:2633)
- Dolichocephaly (HP:0000268): An abnormality of skull shape characterized by a increased anterior-posterior diameter, i.e., an increased antero-posterior dimension of the skull. Cephalic index less than 76%. Alternatively, an apparently increased antero-posterior length of the head compared to width. Often due to premature closure of the sagittal suture. Evidence: TAS. Frequency: Occasional (HP:0040283). (ORPHA:2633)
- Strabismus (HP:0000486): A misalignment of the eyes so that the visual axes deviate from bifoveal fixation. The classification of strabismus may be based on a number of features including the relative position of the eyes, whether the deviation is latent or manifest, intermittent or constant, concomitant or otherwise and according to the age of onset and the relevance of any associated refractive error. Evidence: TAS. Frequency: Occasional (HP:0040283). (ORPHA:2633)
- Sacral dimple (HP:0000960): A cutaneous indentation resulting from tethering of the skin to underlying structures (bone) of the intergluteal cleft. Evidence: TAS. Frequency: Occasional (HP:0040283). (ORPHA:2633)
- Intellectual disability (HP:0001249): The term intellectual disability or intellectual developmental disorder is used to describe significantly sub-average intellectual and adaptive functioning based on clinical assessment and as measured by individually administered, appropriately normed, standardized and validated tests of intellectual functioning and adaptive behavior, with onset during the developmental period from infancy through adolescence. Evidence: TAS. Frequency: Occasional (HP:0040283). (ORPHA:2633)
- Scoliosis (HP:0002650): The presence of an abnormal lateral curvature of the spine. Evidence: TAS. Frequency: Occasional (HP:0040283). (ORPHA:2633)
- Genu varum (HP:0002970): A positional abnormality marked by outward bowing of the legs in which the knees stay wide apart when a person stands with the feet and ankles together. Evidence: TAS. Frequency: Occasional (HP:0040283). (ORPHA:2633)
- Abnormality of the wrist (HP:0003019): Abnormality of the wrist, the structure connecting the hand and the forearm. Evidence: TAS. Frequency: Occasional (HP:0040283). (ORPHA:2633)
- Clinodactyly of the 5th finger (HP:0004209): Clinodactyly refers to a bending or curvature of the fifth finger in the radial direction (i.e., towards the 4th finger). Evidence: TAS. Frequency: Occasional (HP:0040283). (ORPHA:2633)
- Finger syndactyly (HP:0006101): Webbing or fusion of the fingers, involving soft parts only or including bone structure. Bony fusions are referred to as "bony" Syndactyly if the fusion occurs in a radio-ulnar axis. Fusions of bones of the fingers in a proximo-distal axis are referred to as "Symphalangism". Evidence: TAS. Frequency: Occasional (HP:0040283). (ORPHA:2633)
- Bilateral single transverse palmar creases (HP:0007598): The distal and proximal transverse palmar creases are merged into a single transverse palmar crease on both hands. Evidence: TAS. Frequency: Occasional (HP:0040283). (ORPHA:2633)
- Large face (HP:0100729). Evidence: TAS. Frequency: Occasional (HP:0040283). (ORPHA:2633)